- Shawl scrotum (HP:0000049): Superior margin of the scrotum superior to the base of the penis. Evidence: TAS. Frequency: Frequent (HP:0040282). (ORPHA:85277)
- Short philtrum (HP:0000322): Distance between nasal base and midline upper lip vermilion border more than 2 SD below the mean. Alternatively, an apparently decreased distance between nasal base and midline upper lip vermilion border. Evidence: TAS. Frequency: Very frequent (HP:0040281). (ORPHA:85277)
- Esotropia (HP:0000565): A form of strabismus with one or both eyes turned inward ('crossed') to a relatively severe degree, usually defined as 10 diopters or more. Evidence: TAS. Frequency: Frequent (HP:0040282). (ORPHA:85277)
- Autistic behavior (HP:0000729): Persistent deficits in social interaction and communication and interaction as well as a markedly restricted repertoire of activity and interest as well as repetitive patterns of behavior. Evidence: TAS. Frequency: Very frequent (HP:0040281). (ORPHA:85277)
- Motor stereotypy (HP:0000733): Use of the same abnormal action in response to certain triggers or at random. They may be used as a way to regulate one's internal state but must otherwise have no apparent functional purpose. Evidence: TAS. Frequency: Very frequent (HP:0040281). (ORPHA:85277)
- Intellectual disability (HP:0001249): The term intellectual disability or intellectual developmental disorder is used to describe significantly sub-average intellectual and adaptive functioning based on clinical assessment and as measured by individually administered, appropriately normed, standardized and validated tests of intellectual functioning and adaptive behavior, with onset during the developmental period from infancy through adolescence. Evidence: TAS. Frequency: Very frequent (HP:0040281). (ORPHA:85277)
- Seizure (HP:0001250): A seizure is an intermittent abnormality of nervous system physiology characterized by a transient occurrence of signs and/or symptoms due to abnormal excessive or synchronous neuronal activity in the brain. Evidence: TAS. Frequency: Frequent (HP:0040282). (ORPHA:85277)
- Neonatal hypotonia (HP:0001319): Muscular hypotonia (abnormally low muscle tone) manifesting in the neonatal period. Evidence: TAS. Frequency: Very frequent (HP:0040281). (ORPHA:85277)
- Absent speech (HP:0001344): Complete lack of development of speech and language abilities. Evidence: TAS. Frequency: Very frequent (HP:0040281). (ORPHA:85277)
- Gastroesophageal reflux (HP:0002020): A condition in which the stomach contents leak backwards from the stomach into the esophagus through the lower esophageal sphincter. Evidence: TAS. Frequency: Frequent (HP:0040282). (ORPHA:85277)
- Hypoplasia of the corpus callosum (HP:0002079): Underdevelopment of the corpus callosum. Evidence: TAS. Frequency: Frequent (HP:0040282). (ORPHA:85277)
- Ventriculomegaly (HP:0002119): An increase in size of the ventricular system of the brain. Evidence: TAS. Frequency: Frequent (HP:0040282). (ORPHA:85277)
- Cerebral cortical atrophy (HP:0002120): Atrophy of the cortex of the cerebrum. Evidence: TAS. Frequency: Very frequent (HP:0040281). (ORPHA:85277)
- Tetraparesis (HP:0002273): Weakness of all four limbs. Evidence: TAS. Frequency: Very frequent (HP:0040281). (ORPHA:85277)
- Abnormality of the musculature (HP:0003011): Abnormality originating in one or more muscles, i.e., of the set of muscles of body. Evidence: TAS. Frequency: Frequent (HP:0040282). (ORPHA:85277)
- Short nose (HP:0003196): Distance from nasion to subnasale more than two standard deviations below the mean, or alternatively, an apparently decreased length from the nasal root to the nasal tip. Evidence: TAS. Frequency: Very frequent (HP:0040281). (ORPHA:85277)
- Tented upper lip vermilion (HP:0010804): Triangular appearance of the oral aperture with the apex in the midpoint of the upper vermilion and the lower vermilion forming the base. Evidence: TAS. Frequency: Very frequent (HP:0040281). (ORPHA:85277)
- Severe global developmental delay (HP:0011344): A severe delay in the achievement of motor or mental milestones in the domains of development of a child. Evidence: TAS. Frequency: Very frequent (HP:0040281). (ORPHA:85277)
These phenotypes are associated with the disease X-linked intellectual disability, Cantagrel type (ORPHA:85277).